- Yellow-brown discoloration of the teeth (HP:0006286). Evidence: PCS. (PMID:11175779)
- Dentinogenesis imperfecta (HP:0000703): Developmental dysplasia of dentin. Evidence: PCS. (PMID:11175779)
- Autosomal dominant inheritance (HP:0000006): A mode of inheritance that is observed for traits related to a gene encoded on one of the autosomes (i.e., the human chromosomes 1-22) in which a trait manifests in heterozygotes. In the context of medical genetics, an autosomal dominant disorder is caused when a single copy of the mutant allele is present. Males and females are affected equally, and can both transmit the disorder with a risk of 50% for each child of inheriting the mutant allele. Evidence: PCS. (PMID:11175779)
These phenotypes are associated with the disease dentinogenesis imperfecta type 2 (OMIM:125490).